Phenotypes associated with the disease 2q31.1 microdeletion syndrome (ORPHA:251014):
- Intellectual disability (HP:0001249): The term intellectual disability or intellectual developmental disorder is used to describe significantly sub-average intellectual and adaptive functioning based on clinical assessment and as measured by individually administered, appropriately normed, standardized and validated tests of intellectual functioning and adaptive behavior, with onset during the developmental period from infancy through adolescence. Evidence: TAS. Frequency: Very frequent (HP:0040281). (ORPHA:251014)
- Global developmental delay (HP:0001263): A delay in the achievement of motor or mental milestones in the domains of development of a child, including motor skills, speech and language, cognitive skills, and social and emotional skills. This term should only be used to describe children younger than five years of age. Evidence: TAS. Frequency: Very frequent (HP:0040281). (ORPHA:251014)
- Microcephaly (HP:0000252): Head circumference below 2 standard deviations below the mean for age and gender. Evidence: TAS. Frequency: Frequent (HP:0040282). (ORPHA:251014)
- Long philtrum (HP:0000343): Distance between nasal base and midline upper lip vermilion border more than 2 SD above the mean. Alternatively, an apparently increased distance between nasal base and midline upper lip vermilion border. Evidence: TAS. Frequency: Frequent (HP:0040282). (ORPHA:251014)
- Micrognathia (HP:0000347): Developmental hypoplasia of the mandible. Evidence: TAS. Frequency: Frequent (HP:0040282). (ORPHA:251014)
- Low-set ears (HP:0000369): Upper insertion of the ear to the scalp below an imaginary horizontal line drawn between the inner canthi of the eye and extending posteriorly to the ear. Evidence: TAS. Frequency: Frequent (HP:0040282). (ORPHA:251014)
- Bulbous nose (HP:0000414): Increased volume and globular shape of the anteroinferior aspect of the nose. Evidence: TAS. Frequency: Frequent (HP:0040282). (ORPHA:251014)
- Short neck (HP:0000470): Diminished length of the neck. Evidence: TAS. Frequency: Frequent (HP:0040282). (ORPHA:251014)
- Downslanted palpebral fissures (HP:0000494): The palpebral fissure inclination is more than two standard deviations below the mean. Evidence: TAS. Frequency: Frequent (HP:0040282). (ORPHA:251014)
- Brachydactyly (HP:0001156): Digits that appear disproportionately short compared to the hand/foot. The word brachydactyly is used here to describe a series distinct patterns of shortened digits (brachydactyly types A-E). This is the sense used here. Evidence: TAS. Frequency: Frequent (HP:0040282). (ORPHA:251014)
- Tapered finger (HP:0001182): The gradual reduction in girth of the finger from proximal to distal. Evidence: TAS. Frequency: Frequent (HP:0040282). (ORPHA:251014)
- Seizure (HP:0001250): A seizure is an intermittent abnormality of nervous system physiology characterized by a transient occurrence of signs and/or symptoms due to abnormal excessive or synchronous neuronal activity in the brain. Evidence: TAS. Frequency: Frequent (HP:0040282). (ORPHA:251014)
- Hypotonia (HP:0001252): Hypotonia is an abnormally low muscle tone (the amount of tension or resistance to movement in a muscle). Even when relaxed, muscles have a continuous and passive partial contraction which provides some resistance to passive stretching. Hypotonia thus manifests as diminished resistance to passive stretching. Hypotonia is not the same as muscle weakness, although the two conditions can co-exist. Evidence: TAS. Frequency: Frequent (HP:0040282). (ORPHA:251014)
- Abnormal hair morphology (HP:0001595): An abnormality of the hair. Evidence: TAS. Frequency: Frequent (HP:0040282). (ORPHA:251014)
- Toe syndactyly (HP:0001770): Webbing or fusion of the toes, involving soft parts only or including bone structure. Bony fusions are referred to as "bony" Syndactyly if the fusion occurs in a radio-ulnar axis. Fusions of bones of the toes in a proximo-distal axis are referred to as "Symphalangism". Evidence: TAS. Frequency: Frequent (HP:0040282). (ORPHA:251014)
- Hypoplastic toenails (HP:0001800): Underdevelopment of the toenail. Evidence: TAS. Frequency: Frequent (HP:0040282). (ORPHA:251014)
- Sandal gap (HP:0001852): A widely spaced gap between the first toe (the great toe) and the second toe. Evidence: TAS. Frequency: Frequent (HP:0040282). (ORPHA:251014)
- Deep philtrum (HP:0002002): Accentuated, prominent philtral ridges giving rise to an exaggerated groove in the midline between the nasal base and upper vermillion border. Evidence: TAS. Frequency: Frequent (HP:0040282). (ORPHA:251014)
- Language impairment (HP:0002463): Language impairment is a deficit in comprehension or production of language that includes reduced vocabulary, limited sentence structure, or impairments in written or spoken communication. Language abilities are substantially and quantifiably below age expectations. Evidence: TAS. Frequency: Frequent (HP:0040282). (ORPHA:251014)
- Downturned corners of mouth (HP:0002714): A morphological abnormality of the mouth in which the angle of the mouth is downturned. The oral commissures are positioned inferior to the midline labial fissure. Evidence: TAS. Frequency: Frequent (HP:0040282). (ORPHA:251014)
- Delayed skeletal maturation (HP:0002750): A decreased rate of skeletal maturation. Delayed skeletal maturation can be diagnosed on the basis of an estimation of the bone age from radiographs of specific bones in the human body. Evidence: TAS. Frequency: Frequent (HP:0040282). (ORPHA:251014)
- Vertebral segmentation defect (HP:0003422): An abnormality related to a defect of vertebral separation during development. Evidence: TAS. Frequency: Frequent (HP:0040282). (ORPHA:251014)
- Clinodactyly of the 5th finger (HP:0004209): Clinodactyly refers to a bending or curvature of the fifth finger in the radial direction (i.e., towards the 4th finger). Evidence: TAS. Frequency: Frequent (HP:0040282). (ORPHA:251014)
- Short stature (HP:0004322): A height below that which is expected according to age and gender norms. Although there is no universally accepted definition of short stature, many refer to "short stature" as height more than 2 standard deviations below the mean for age and gender (or below the 3rd percentile for age and gender dependent norms). Evidence: TAS. Frequency: Frequent (HP:0040282). (ORPHA:251014)
- Prominent metopic ridge (HP:0005487): Vertical bony ridge positioned in the midline of the forehead. Evidence: TAS. Frequency: Frequent (HP:0040282). (ORPHA:251014)
- Abnormal metacarpal morphology (HP:0005916): Any abnormal shape or structure of the metacarpal bones. Evidence: TAS. Frequency: Frequent (HP:0040282). (ORPHA:251014)
- Broad hallux phalanx (HP:0010059): An increase in width in one or more phalanges of the big toe. Evidence: TAS. Frequency: Frequent (HP:0040282). (ORPHA:251014)
- Short palpebral fissure (HP:0012745): Distance between the medial and lateral canthi is more than 2 SD below the mean for age (objective); or, apparently reduced length of the palpebral fissures. Evidence: TAS. Frequency: Frequent (HP:0040282). (ORPHA:251014)
- Camptodactyly of finger (HP:0100490): The distal interphalangeal joint and/or the proximal interphalangeal joint of the fingers cannot be extended to 180 degrees by either active or passive extension. Evidence: TAS. Frequency: Frequent (HP:0040282). (ORPHA:251014)
- Inguinal hernia (HP:0000023): Protrusion of the contents of the abdominal cavity through the inguinal canal. Evidence: TAS. Frequency: Occasional (HP:0040283). (ORPHA:251014)
- Cryptorchidism (HP:0000028): Testis in inguinal canal. That is, absence of one or both testes from the scrotum owing to failure of the testis or testes to descend through the inguinal canal to the scrotum. Evidence: TAS. Frequency: Occasional (HP:0040283). (ORPHA:251014)
- Cleft palate (HP:0000175): Cleft palate is a developmental defect of the palate resulting from a failure of fusion of the palatine processes and manifesting as a separation of the roof of the mouth (soft and hard palate). Evidence: TAS. Frequency: Occasional (HP:0040283). (ORPHA:251014)
- Everted lower lip vermilion (HP:0000232): An abnormal configuration of the lower lip such that it is turned outward i.e., everted, with the Inner aspect of the lower lip vermilion (normally opposing the teeth) being visible in a frontal view. Evidence: TAS. Frequency: Occasional (HP:0040283). (ORPHA:251014)
- Thin vermilion border (HP:0000233): Height of the vermilion of the medial part of the lip more than 2 SD below the mean, or apparently reduced height of the vermilion of the lip in the frontal view. The vermilion is the red part of the lips (and confusingly, the vermilion itself is also often referred to as being equivalent the lips). Evidence: TAS. Frequency: Occasional (HP:0040283). (ORPHA:251014)
- Trigonocephaly (HP:0000243): Wedge-shaped, or triangular head, with the apex of the triangle at the midline of the forehead and the base of the triangle at the occiput. Evidence: TAS. Frequency: Occasional (HP:0040283). (ORPHA:251014)
- Narrow face (HP:0000275): Bizygomatic (upper face) and bigonial (lower face) width are both more than 2 standard deviations below the mean (objective); or, an apparent reduction in the width of the upper and lower face (subjective). Evidence: TAS. Frequency: Occasional (HP:0040283). (ORPHA:251014)
- Coarse facial features (HP:0000280): Absence of fine and sharp appearance of brows, nose, lips, mouth, and chin, usually because of rounded and heavy features or thickened skin with or without thickening of subcutaneous and bony tissues. Evidence: TAS. Frequency: Occasional (HP:0040283). (ORPHA:251014)
- Epicanthus (HP:0000286): A fold of skin starting above the medial aspect of the upper eyelid and arching downward to cover, pass in front of and lateral to the medial canthus. Evidence: TAS. Frequency: Occasional (HP:0040283). (ORPHA:251014)
- Low anterior hairline (HP:0000294): Distance between the hairline (trichion) and the glabella (the most prominent point on the frontal bone above the root of the nose), in the midline, more than two SD below the mean. Alternatively, an apparently decreased distance between the hairline and the glabella. Evidence: TAS. Frequency: Occasional (HP:0040283). (ORPHA:251014)
- Hypertelorism (HP:0000316): Interpupillary distance more than 2 SD above the mean (alternatively, the appearance of an increased interpupillary distance or widely spaced eyes). Evidence: TAS. Frequency: Occasional (HP:0040283). (ORPHA:251014)
- Facial asymmetry (HP:0000324): An abnormal difference between the left and right sides of the face. Evidence: TAS. Frequency: Occasional (HP:0040283). (ORPHA:251014)
- Strabismus (HP:0000486): A misalignment of the eyes so that the visual axes deviate from bifoveal fixation. The classification of strabismus may be based on a number of features including the relative position of the eyes, whether the deviation is latent or manifest, intermittent or constant, concomitant or otherwise and according to the age of onset and the relevance of any associated refractive error. Evidence: TAS. Frequency: Occasional (HP:0040283). (ORPHA:251014)
- Ptosis (HP:0000508): The upper eyelid margin is positioned 3 mm or more lower than usual and covers the superior portion of the iris (objective); or, the upper lid margin obscures at least part of the pupil (subjective). Evidence: TAS. Frequency: Occasional (HP:0040283). (ORPHA:251014)
- Proptosis (HP:0000520): An eye that is protruding anterior to the plane of the face to a greater extent than is typical. Evidence: TAS. Frequency: Occasional (HP:0040283). (ORPHA:251014)
- Microphthalmia (HP:0000568): A developmental anomaly characterized by abnormal smallness of one or both eyes. Evidence: TAS. Frequency: Occasional (HP:0040283). (ORPHA:251014)
- Optic disc coloboma (HP:0000588): A cleft of the optic nerve that extends inferiorly. Evidence: TAS. Frequency: Occasional (HP:0040283). (ORPHA:251014)
- Coloboma (HP:0000589): A developmental defect characterized by a cleft of some portion of the eye or ocular adnexa. Evidence: TAS. Frequency: Occasional (HP:0040283). (ORPHA:251014)
- Iris coloboma (HP:0000612): A coloboma of the iris. Evidence: TAS. Frequency: Occasional (HP:0040283). (ORPHA:251014)
- Synophrys (HP:0000664): Meeting of the medial eyebrows in the midline. Evidence: TAS. Frequency: Occasional (HP:0040283). (ORPHA:251014)
- Abnormality of the hypothalamus-pituitary axis (HP:0000864): Abnormality of the pituitary gland (also known as hypophysis), which is an endocrine gland that protrudes from the bottom of the hypothalamus at the base of the brain. The pituitary gland secretes the hormones ACTH, TSH, PRL, GH, endorphins, FSH, LH, oxytocin, and antidiuretic hormone. The secretion of hormones from the anterior pituitary is under the strict control of hypothalamic hormones, and the posterior pituitary is essentially an extension of the hypothalamus, so that hypothalamus and pituitary gland may be regarded as a functional unit. Evidence: TAS. Frequency: Occasional (HP:0040283). (ORPHA:251014)
- Ventricular septal defect (HP:0001629): A hole between the two bottom chambers (ventricles) of the heart. The defect is centered around the most superior aspect of the ventricular septum. Evidence: TAS. Frequency: Occasional (HP:0040283). (ORPHA:251014)
- Atrial septal defect (HP:0001631): Atrial septal defect (ASD) is a congenital abnormality of the interatrial septum that enables blood flow between the left and right atria via the interatrial septum. Evidence: TAS. Frequency: Occasional (HP:0040283). (ORPHA:251014)
- Short foot (HP:0001773): A measured foot length that is more than 2 SD below the mean for a newborn of 27 - 41 weeks gestation, or foot that is less than the 3rd centile for individuals from birth to 16 years of age (objective). Alternatively, a foot that appears disproportionately short (subjective). Evidence: TAS. Frequency: Occasional (HP:0040283). (ORPHA:251014)
- Ventriculomegaly (HP:0002119): An increase in size of the ventricular system of the brain. Evidence: TAS. Frequency: Occasional (HP:0040283). (ORPHA:251014)
- Cerebral cortical atrophy (HP:0002120): Atrophy of the cortex of the cerebrum. Evidence: TAS. Frequency: Occasional (HP:0040283). (ORPHA:251014)
- Scoliosis (HP:0002650): The presence of an abnormal lateral curvature of the spine. Evidence: TAS. Frequency: Occasional (HP:0040283). (ORPHA:251014)
- Kyphosis (HP:0002808): Exaggerated anterior convexity of the thoracic vertebral column. Evidence: TAS. Frequency: Occasional (HP:0040283). (ORPHA:251014)
- Abnormal fibula morphology (HP:0002991): An anomaly of the calf bone (fibula), one of the two bones of the calf. Evidence: TAS. Frequency: Occasional (HP:0040283). (ORPHA:251014)
- Abnormal tibia morphology (HP:0002992): Abnormality of the tibia (shinbone). Evidence: TAS. Frequency: Occasional (HP:0040283). (ORPHA:251014)
- Short palm (HP:0004279): Short palm. Evidence: TAS. Frequency: Occasional (HP:0040283). (ORPHA:251014)
- Finger syndactyly (HP:0006101): Webbing or fusion of the fingers, involving soft parts only or including bone structure. Bony fusions are referred to as "bony" Syndactyly if the fusion occurs in a radio-ulnar axis. Fusions of bones of the fingers in a proximo-distal axis are referred to as "Symphalangism". Evidence: TAS. Frequency: Occasional (HP:0040283). (ORPHA:251014)
- Abnormal morphology of ulna (HP:0040071): Any structural anomaly of the ulna, a bone of the forearm the extends from the elbow to the little finger. Evidence: TAS. Frequency: Occasional (HP:0040283). (ORPHA:251014)
- Ectrodactyly (HP:0100257): A condition in which middle parts of the hands and/or feet (digits and meta-carpals and -tarsals) are missing giving a cleft appearance. The severity is very variable ranging from slightly hypoplastic 3rd toe/fingers over absent 2nd or 3rd toes/fingers as far as oligo- or monodactyl hands and/or feet. Evidence: TAS. Frequency: Occasional (HP:0040283). (ORPHA:251014)